Phenotypes associated with the disease MALT lymphoma (ORPHA:52417):
- Visual impairment (HP:0000505): Visual impairment (or vision impairment) is vision loss (of a person) to such a degree as to qualify as an additional support need through a significant limitation of visual capability resulting from either disease, trauma, or congenital or degenerative conditions that cannot be corrected by conventional means, such as refractive correction, medication, or surgery. Evidence: TAS. Frequency: Occasional (HP:0040283). (ORPHA:52417)
- Abnormal nasolacrimal system morphology (HP:0000614): An abnormality of the nasolacrimal drainage system, which serves as a conduit for tear flow from the external eye to the nasal cavity. Evidence: TAS. Frequency: Occasional (HP:0040283). (ORPHA:52417)
- Abnormality of the thyroid gland (HP:0000820): An abnormality of the thyroid gland. Evidence: TAS. Frequency: Occasional (HP:0040283). (ORPHA:52417)
- Weight loss (HP:0001824): Reduction of total body weight. Evidence: TAS. Frequency: Very frequent (HP:0040281). (ORPHA:52417)
- Anemia (HP:0001903): A reduction in erythrocytes volume or hemoglobin concentration. Evidence: TAS. Frequency: Very frequent (HP:0040281). (ORPHA:52417)
- Fever (HP:0001945): Body temperature elevated above the normal range. Evidence: TAS. Frequency: Very frequent (HP:0040281). (ORPHA:52417)
- Nausea and vomiting (HP:0002017): Nausea is a commonly encountered symptom that has been defined as an unpleasant painless subjective feeling that one will imminently vomit. Vomiting has been defined as the forceful expulsion of the contents of the stomach, duodenum, or jejunum through the oral cavity. While nausea and vomiting are often thought to exist on a temporal continuum, this is not always the case. There are situations when severe nausea may be present without emesis and less frequently, when emesis may be present without preceding nausea. Evidence: TAS. Frequency: Very frequent (HP:0040281). (ORPHA:52417)
- Abdominal pain (HP:0002027): An unpleasant sensation characterized by physical discomfort (such as pricking, throbbing, or aching) and perceived to originate in the abdomen. Evidence: TAS. Frequency: Occasional (HP:0040283). (ORPHA:52417)
- Pulmonary infiltrates (HP:0002113). Evidence: TAS. Frequency: Very frequent (HP:0040281). (ORPHA:52417)
- Recurrent respiratory infections (HP:0002205): An increased susceptibility to respiratory infections as manifested by a history of recurrent respiratory infections. Evidence: TAS. Frequency: Occasional (HP:0040283). (ORPHA:52417)
- Lymphadenopathy (HP:0002716): Enlargement (swelling) of a lymph node. Evidence: TAS. Frequency: Occasional (HP:0040283). (ORPHA:52417)
- B-cell lymphoma (HP:0012191): A type of lymphoma that originates in B-cells. Evidence: TAS. Frequency: Very frequent (HP:0040281). (ORPHA:52417)
- Fatigue (HP:0012378): A subjective feeling of tiredness characterized by a lack of energy and motivation. Evidence: TAS. Frequency: Very frequent (HP:0040281). (ORPHA:52417)
- Mediastinal lymphadenopathy (HP:0100721): Swelling of lymph nodes within the mediastinum, the central compartment of the thoracic cavities that contains the heart and the great vessels, the esophagus, and trachea and other structures including lymph nodes. Evidence: TAS. Frequency: Occasional (HP:0040283). (ORPHA:52417)
- Hyperhidrosis (HP:0000975): Abnormal excessive perspiration (sweating) despite the lack of appropriate stimuli like hot and humid weather. Evidence: TAS. Frequency: Very frequent (HP:0040281). (ORPHA:52417)
- Constipation (HP:0002019): Infrequent or difficult evacuation of feces. Evidence: TAS. Frequency: Frequent (HP:0040282). (ORPHA:52417)
- Posterior uveitis (HP:0012123): Inflammation of the uveal tract in which the primary site of inflammation is the retina or choroid. Evidence: TAS. Frequency: Occasional (HP:0040283). (ORPHA:52417)